- Cleft palate (HP:0000175): Cleft palate is a developmental defect of the palate resulting from a failure of fusion of the palatine processes and manifesting as a separation of the roof of the mouth (soft and hard palate). Evidence: TAS. Frequency: Occasional (HP:0040283). (ORPHA:957)
- Pectus excavatum (HP:0000767): A defect of the chest wall characterized by a depression of the sternum, giving the chest ("pectus") a caved-in ("excavatum") appearance. Evidence: TAS. Frequency: Very frequent (HP:0040281). (ORPHA:957)
- Triphalangeal thumb (HP:0001199): A thumb with three phalanges in a single, proximo-distal axis. Thus, this term applies if the thumb has an accessory phalanx, leading to a digit like appearance of the thumb. Evidence: TAS. Frequency: Very frequent (HP:0040281). (ORPHA:957)
- Mild intellectual disability (HP:0001256): Mild intellectual disability (ID) is defined as a type of ID characterized by mildly sub-average adaptive functioning and intellectual functioning, with an intelligence quotient (IQ) the range of 50-69. Evidence: TAS. Frequency: Frequent (HP:0040282). (ORPHA:957)
- Spina bifida (HP:0002414): Incomplete closure of the embryonic neural tube, whereby some vertebral arches remain unfused and open. The mildest form is spina bifida occulta, followed by meningocele and meningomyelocele. Evidence: TAS. Frequency: Frequent (HP:0040282). (ORPHA:957)
- High, narrow palate (HP:0002705): The presence of a high and narrow palate. Evidence: TAS. Frequency: Occasional (HP:0040283). (ORPHA:957)
- Synostosis of carpal bones (HP:0005048). Evidence: TAS. Frequency: Very frequent (HP:0040281). (ORPHA:957)
- Finger syndactyly (HP:0006101): Webbing or fusion of the fingers, involving soft parts only or including bone structure. Bony fusions are referred to as "bony" Syndactyly if the fusion occurs in a radio-ulnar axis. Fusions of bones of the fingers in a proximo-distal axis are referred to as "Symphalangism". Evidence: TAS. Frequency: Very frequent (HP:0040281). (ORPHA:957)
- Tarsal synostosis (HP:0008368): Synostosis (bony fusion) involving one or more bones of the tarsus (calcaneus, talus, cuboid, navicular, cuneiiform bones). Evidence: TAS. Frequency: Very frequent (HP:0040281). (ORPHA:957)
- Short distal phalanx of finger (HP:0009882): Short distance from the end of the finger to the most distal interphalangeal crease or the distal interphalangeal joint flexion point. That is, hypoplasia of one or more of the distal phalanx of finger. Evidence: TAS. Frequency: Very frequent (HP:0040281). (ORPHA:957)
- Broad thumb (HP:0011304): Increased thumb width without increased dorso-ventral dimension. Evidence: TAS. Frequency: Very frequent (HP:0040281). (ORPHA:957)
- Camptodactyly of finger (HP:0100490): The distal interphalangeal joint and/or the proximal interphalangeal joint of the fingers cannot be extended to 180 degrees by either active or passive extension. Evidence: TAS. Frequency: Occasional (HP:0040283). (ORPHA:957)
These phenotypes are associated with the disease Acropectorovertebral dysplasia (ORPHA:957).